- Irritability (HP:0000737): An emotional state characterized by negative feelings of heightened frustration, annoyance, or feeling upset, often triggered by internal factors (e.g., fatigue, hunger, unfulfilled desires) or external factors (e.g., social or environmental challenges). Irritability may be unpredictable, and is accompanied by a lowered threshold for emotional reactivity and observable features (speech, facial expressions, or psychomotor activity). Evidence: TAS. Frequency: Frequent (HP:0040282). (ORPHA:69077)
- Hematuria (HP:0000790): The presence of blood in the urine. Hematuria may be gross hematuria (visible to the naked eye) or microscopic hematuria (detected by dipstick or microscopic examination of the urine). Evidence: TAS. Frequency: Frequent (HP:0040282). (ORPHA:69077)
- Hypertension (HP:0000822): The presence of chronic increased pressure in the systemic arterial system. Evidence: TAS. Frequency: Frequent (HP:0040282). (ORPHA:69077)
- Subcutaneous nodule (HP:0001482): Slightly elevated lesions on or in the skin with a diameter of over 5 mm. Evidence: TAS. Frequency: Frequent (HP:0040282). (ORPHA:69077)
- Weight loss (HP:0001824): Reduction of total body weight. Evidence: TAS. Frequency: Frequent (HP:0040282). (ORPHA:69077)
- Thrombocytopenia (HP:0001873): A reduction in the number of circulating thrombocytes. Evidence: TAS. Frequency: Occasional (HP:0040283). (ORPHA:69077)
- Anemia (HP:0001903): A reduction in erythrocytes volume or hemoglobin concentration. Evidence: TAS. Frequency: Occasional (HP:0040283). (ORPHA:69077)
- Fever (HP:0001945): Body temperature elevated above the normal range. Evidence: TAS. Frequency: Frequent (HP:0040282). (ORPHA:69077)
- Nausea and vomiting (HP:0002017): Nausea is a commonly encountered symptom that has been defined as an unpleasant painless subjective feeling that one will imminently vomit. Vomiting has been defined as the forceful expulsion of the contents of the stomach, duodenum, or jejunum through the oral cavity. While nausea and vomiting are often thought to exist on a temporal continuum, this is not always the case. There are situations when severe nausea may be present without emesis and less frequently, when emesis may be present without preceding nausea. Evidence: TAS. Frequency: Frequent (HP:0040282). (ORPHA:69077)
- Abdominal pain (HP:0002027): An unpleasant sensation characterized by physical discomfort (such as pricking, throbbing, or aching) and perceived to originate in the abdomen. Evidence: TAS. Frequency: Frequent (HP:0040282). (ORPHA:69077)
- Respiratory insufficiency (HP:0002093). Evidence: TAS. Frequency: Frequent (HP:0040282). (ORPHA:69077)
- Hemiplegia (HP:0002301): Paralysis (complete loss of muscle function) in the arm, leg, and in some cases the face on one side of the body. Evidence: TAS. Frequency: Occasional (HP:0040283). (ORPHA:69077)
- Headache (HP:0002315): Cephalgia, or pain sensed in various parts of the head, not confined to the area of distribution of any nerve. Evidence: TAS. Frequency: Frequent (HP:0040282). (ORPHA:69077)
- Lymphadenopathy (HP:0002716): Enlargement (swelling) of a lymph node. Evidence: TAS. Frequency: Frequent (HP:0040282). (ORPHA:69077)
- Neoplasm of the liver (HP:0002896): A tumor (abnormal growth of tissue) of the liver. Evidence: TAS. Frequency: Frequent (HP:0040282). (ORPHA:69077)
- Hypercalcemia (HP:0003072): The concentration of calcium in the blood circulation is above the upper limit of normal. Evidence: TAS. Frequency: Occasional (HP:0040283). (ORPHA:69077)
- Poor appetite (HP:0004396): A reduced desire to eat. Evidence: TAS. Frequency: Frequent (HP:0040282). (ORPHA:69077)
- Cranial nerve paralysis (HP:0006824). Evidence: TAS. Frequency: Frequent (HP:0040282). (ORPHA:69077)
- Renal neoplasm (HP:0009726): The presence of a neoplasm of the kidney. Evidence: TAS. Frequency: Frequent (HP:0040282). (ORPHA:69077)
- Internal hemorrhage (HP:0011029): The presence of hemorrhage within the body. Evidence: TAS. Frequency: Frequent (HP:0040282). (ORPHA:69077)
- Oculomotor nerve palsy (HP:0012246): Reduced ability to control the movement of the eye associated with damage to the third cranial nerve (the oculomotor nerve). Evidence: TAS. Frequency: Frequent (HP:0040282). (ORPHA:69077)
- Neoplasm of the central nervous system (HP:0100006): A neoplasm of the central nervous system. Evidence: TAS. Frequency: Frequent (HP:0040282). (ORPHA:69077)
- Cerebral palsy (HP:0100021): Cerebral palsy describes a group of permanent disorders of the development of movement and posture, causing activity limitation, that are attributed to nonprogressive disturbances that occurred in the developing fetal or infant brain. The motor disorders of cerebral palsy are often accompanied by disturbances of sensation, perception, cognition, communication, and behavior, by epilepsy, and by secondary musculoskeletal problems. Evidence: TAS. Frequency: Frequent (HP:0040282). (ORPHA:69077)
- Sarcoma (HP:0100242): A connective tissue neoplasm formed by proliferation of mesodermal cells. Bone and soft tissue sarcomas are the main types of sarcoma. Sarcoma is usually highly malignant. Evidence: TAS. Frequency: Frequent (HP:0040282). (ORPHA:69077)
These phenotypes are associated with the disease Rhabdoid tumor (ORPHA:69077).